- Neonatal respiratory distress (HP:0002643): Respiratory difficulty as newborn. Evidence: TAS. Frequency: Very frequent (HP:0040281). (ORPHA:217563)
- Tachypnea (HP:0002789): Very rapid breathing. Evidence: TAS. Frequency: Very frequent (HP:0040281). (ORPHA:217563)
- Intraalveolar phospholipid accumulation (HP:0006517): Accumulation of amorphous PAS-positive material in the space between alveolar macrophages, sometimes as condensed form (oval bodies) are typically found in alveolar proteinosis. Evidence: TAS. Frequency: Very frequent (HP:0040281). (ORPHA:217563)
- Abnormal pulmonary interstitial morphology (HP:0006530): Abnormality of the lung parenchyma extending to the pulmonary interstitium and leading to diffuse pulmonary fibrosis. Evidence: TAS. Frequency: Very frequent (HP:0040281). (ORPHA:217563)
- Pulmonary arterial hypertension (HP:0002092): Pulmonary hypertension is defined mean pulmonary artery pressure of 25mmHg or more and pulmonary capillary wedge pressure of 15mmHg or less when measured by right heart catheterisation at rest and in a supine position. Evidence: TAS. Frequency: Frequent (HP:0040282). (ORPHA:217563)
- Pulmonary infiltrates (HP:0002113). Evidence: TAS. Frequency: Frequent (HP:0040282). (ORPHA:217563)
- Pulmonary opacity (HP:0031457): Opacity refers to any area that preferentially attenuates the x-ray beam and therefore appears more opaque than the surrounding area. It is a nonspecific term that does not indicate the size or pathologic nature of the abnormality. Evidence: TAS. Frequency: Frequent (HP:0040282). (ORPHA:217563)
- Right ventricular hypertrophy (HP:0001667): In this case the right ventricle is more muscular than normal, causing a characteristic boot-shaped (coeur-en-sabot) appearance as seen on anterior- posterior chest x-rays. Right ventricular hypertrophy is commonly associated with any form of right ventricular outflow obstruction or pulmonary hypertension, which may in turn owe its origin to left-sided disease. The echocardiographic signs are thickening of the anterior right ventricular wall and the septum. Cavity size is usually normal, or slightly enlarged. In many cases there is associated volume overload present due to tricuspid regurgitation, in the absence of this, septal motion is normal. Evidence: TAS. Frequency: Occasional (HP:0040283). (ORPHA:217563)
- Spontaneous neonatal pneumothorax (HP:0004876): Pneumothorax occurring neonatally without traumatic injury to the chest or lung. Evidence: TAS. Frequency: Occasional (HP:0040283). (ORPHA:217563)
- Interstitial pneumonitis (HP:0006515). Evidence: TAS. Frequency: Occasional (HP:0040283). (ORPHA:217563)
- Chronic lung disease (HP:0006528): According to the definitions of the American and British Thoracic Societies, including pulmonary functional tests, X-rays, and CT scans for items such as fibrosis, bronchiectasis, bullae, emphysema, nodular or lymphomatous abnormalities. Evidence: TAS. Frequency: Occasional (HP:0040283). (ORPHA:217563)
These phenotypes are associated with the disease Neonatal acute respiratory distress syndrome (ORPHA:217563).